Phenotypes associated with the disease myasthenic syndrome, congenital, 22 (OMIM:616224):
- Congenital onset (HP:0003577): A phenotypic abnormality that is present at birth. Evidence: PCS. Frequency: 1/1. (PMID:24610330)
- Tented upper lip vermilion (HP:0010804): Triangular appearance of the oral aperture with the apex in the midpoint of the upper vermilion and the lower vermilion forming the base. Evidence: PCS. Frequency: 1/1. (PMID:24610330)
- Short stature (HP:0004322): A height below that which is expected according to age and gender norms. Although there is no universally accepted definition of short stature, many refer to "short stature" as height more than 2 standard deviations below the mean for age and gender (or below the 3rd percentile for age and gender dependent norms). Evidence: TAS. (OMIM:616224)
- Feeding difficulties (HP:0011968): Impaired ability to eat related to problems gathering food and getting ready to suck, chew, or swallow it. Evidence: PCS. Frequency: 1/1. (PMID:24610330)
- Hypotonia (HP:0001252): Hypotonia is an abnormally low muscle tone (the amount of tension or resistance to movement in a muscle). Even when relaxed, muscles have a continuous and passive partial contraction which provides some resistance to passive stretching. Hypotonia thus manifests as diminished resistance to passive stretching. Hypotonia is not the same as muscle weakness, although the two conditions can co-exist. Evidence: PCS. Frequency: 1/1. (PMID:24610330)
- Cystinuria (HP:0003131): An increased concentration of cystine in the urine. Evidence: PCS. Frequency: 0/1. (PMID:24610330)
- Motor delay (HP:0001270): A type of Developmental delay characterized by a delay in acquiring motor skills. Evidence: TAS. (OMIM:616224)
- Anti-neuromuscular Junction acetylcholine receptor antibody positivity (HP:0030208): The presence of autoantibodies (immunoglobulins) in the blood circulation that react against neuromuscular junction acetylcholine receptors. Evidence: PCS. Frequency: 0/1. (PMID:24610330)
- Ptosis (HP:0000508): The upper eyelid margin is positioned 3 mm or more lower than usual and covers the superior portion of the iris (objective); or, the upper lid margin obscures at least part of the pupil (subjective). Evidence: PCS. Frequency: 1/1. (PMID:24610330)
- Autosomal recessive inheritance (HP:0000007): A mode of inheritance that is observed for traits related to a gene encoded on one of the autosomes (i.e., the human chromosomes 1-22) in which a trait manifests in individuals with two pathogenic alleles, either homozygotes (two copies of the same mutant allele) or compound heterozygotes (whereby each copy of a gene has a distinct mutant allele). Evidence: PCS. (PMID:24610330)
- Decreased response to growth hormone stimulation test (HP:0000824): Insufficient responses to growth hormone (GH) provocation tests. GH deficiency is defined as a serum peak GH concentration less than 10 ng/mL on provocation with a combination of at least two separate stimulation tests. Evidence: TAS. (OMIM:616224)
- Waddling gait (HP:0002515): Weakness of the hip girdle and upper thigh muscles, for instance in myopathies, leads to an instability of the pelvis on standing and walking. If the muscles extending the hip joint are affected, the posture in that joint becomes flexed and lumbar lordosis increases. The patients usually have difficulties standing up from a sitting position. Due to weakness in the gluteus medius muscle, the hip on the side of the swinging leg drops with each step (referred to as Trendelenburg sign). The gait appears waddling. The patients frequently attempt to counteract the dropping of the hip on the swinging side by bending the trunk towards the side which is in the stance phase (in the German language literature this is referred to as Duchenne sign). Similar gait patterns can be caused by orthopedic conditions when the origin and the insertion site of the gluteus medius muscle are closer to each other than normal, for instance due to a posttraumatic elevation of the trochanter or pseudarthrosis of the femoral neck. Evidence: PCS. Frequency: 1/1. (PMID:24610330)
- Muscle weakness (HP:0001324): Reduced strength of muscles. Evidence: IEA. (OMIM:616224)
- Proximal muscle weakness (HP:0003701): A lack of strength of the proximal muscles. Evidence: PCS. Frequency: 1/1. (PMID:24610330)